Phenotypes associated with the disease Sebocystomatosis (ORPHA:841):
- Kidney stone (HP:0000787): Kidney stones (calculi) are mineral concretions in the renal calyces and pelvis that are found free or attached to the renal papillae. Evidence: TAS. Frequency: Occasional (HP:0040283). (ORPHA:841)
- Adenoma sebaceum (HP:0009720): The presence of a sebaceous adenoma with origin in the sebum secreting cells of the skin. Evidence: TAS. Frequency: Very frequent (HP:0040281). (ORPHA:841)
- Steatocystoma multiplex (HP:0012035): Multiple, localized or widespread, asymptomatic or inflammatory dermal cysts involving the pilosebaceous units. Lesions can appear anywhere on the body, but steatocystoma multiplex is more commonly involved with those areas of the skin with a high density of developed pilosebaceous units (e.g., the axilla, groin, neck, and proximal extremities). Evidence: TAS. Frequency: Very frequent (HP:0040281). (ORPHA:841)